- Non-Mendelian inheritance (HP:0001426): A mode of inheritance that depends on genetic determinants in more than one gene. Evidence: IEA. (OMIM:607499)
- Bulimia (HP:0100739): A form of anomalous eating behavior characterized by binge eating is followed by self-induced vomiting or other compensatory behavior intended to prevent weight gain (purging, fasting or exercising or a combination of these). Evidence: TAS. (OMIM:607499)
These phenotypes are associated with the disease bulimia nervosa, susceptibility to, 1 (OMIM:607499).